- Skeletal muscle atrophy (HP:0003202): The presence of skeletal muscular atrophy (which is also known as amyotrophy). Evidence: IEA. (OMIM:183050)
- Bradykinesia (HP:0002067): Bradykinesia literally means slow movement, and is used clinically to denote a slowness in the execution of movement (in contrast to hypokinesia, which is used to refer to slowness in the initiation of movement). Evidence: IEA. (OMIM:183050)
- Dysarthria (HP:0001260): Dysarthric speech is a general description referring to a neurological speech disorder characterized by poor articulation. Depending on the involved neurological structures, dysarthria may be further classified as spastic, flaccid, ataxic, hyperkinetic and hypokinetic, or mixed. Evidence: IEA. (OMIM:183050)
- Polyneuropathy (HP:0001271): A generalized disorder of peripheral nerves. Evidence: IEA. (OMIM:183050)
- Rigidity (HP:0002063): Continuous involuntary sustained muscle contraction. When an affected muscle is passively stretched, the degree of resistance remains constant regardless of the rate at which the muscle is stretched. This feature helps to distinguish rigidity from muscle spasticity. Evidence: IEA. (OMIM:183050)
- Ataxia (HP:0001251): Ataxia refers to impaired coordination of voluntary muscle movement. Cerebellar ataxia refers to ataxia due to dysfunction of the cerebellum. This causes a variety of elementary neurological deficits including asynergy (lack of coordination between muscles, limbs and joints), dysmetria (lack of ability to judge distances that can lead to under- or overshoot in grasping movements), and dysdiadochokinesia (inability to perform rapid movements requiring antagonizing muscle groups to be switched on and off repeatedly). Evidence: IEA. (OMIM:183050)
- Fasciculations (HP:0002380): Fasciculations are observed as small, local, involuntary muscle contractions (twitching) visible under the skin. Fasciculations result from increased irritability of an axon (which in turn is often a manifestation of disease of a motor neuron). This leads to sporadic discharges of all the muscle fibers controlled by the axon in isolation from other motor units. Evidence: IEA. (OMIM:183050)
- Decreased nerve conduction velocity (HP:0000762): A reduction in the speed at which electrical signals propagate along the axon of a neuron. Evidence: IEA. (OMIM:183050)
- Spasticity (HP:0001257): A motor disorder characterized by a velocity-dependent increase in tonic stretch reflexes with increased muscle tone, exaggerated (hyperexcitable) tendon reflexes. Evidence: IEA. (OMIM:183050)
- Autosomal dominant inheritance (HP:0000006): A mode of inheritance that is observed for traits related to a gene encoded on one of the autosomes (i.e., the human chromosomes 1-22) in which a trait manifests in heterozygotes. In the context of medical genetics, an autosomal dominant disorder is caused when a single copy of the mutant allele is present. Males and females are affected equally, and can both transmit the disorder with a risk of 50% for each child of inheriting the mutant allele. Evidence: IEA. (OMIM:183050)
These phenotypes are associated with the disease spinocerebellar ataxia with rigidity and peripheral neuropathy (OMIM:183050).